- Neoplasm of the pancreas (HP:0002894): A tumor (abnormal growth of tissue) of the pancreas. Evidence: TAS. Frequency: Very frequent (HP:0040281). (ORPHA:97280)
- Glossitis (HP:0000206): Inflammation of the tongue. Evidence: TAS. Frequency: Frequent (HP:0040282). (ORPHA:97280)
- Diabetes mellitus (HP:0000819): A group of abnormalities characterized by hyperglycemia and glucose intolerance. Evidence: TAS. Frequency: Frequent (HP:0040282). (ORPHA:97280)
- Skin rash (HP:0000988): A red eruption of the skin. Evidence: TAS. Frequency: Frequent (HP:0040282). (ORPHA:97280)
- Pruritus (HP:0000989): Pruritus is an itch or a sensation that makes a person want to scratch. This term refers to an abnormally increased disposition to experience pruritus. Evidence: TAS. Frequency: Frequent (HP:0040282). (ORPHA:97280)
- Weight loss (HP:0001824): Reduction of total body weight. Evidence: TAS. Frequency: Frequent (HP:0040282). (ORPHA:97280)
- Normochromic anemia (HP:0001895). Evidence: TAS. Frequency: Frequent (HP:0040282). (ORPHA:97280)
- Acanthocytosis (HP:0001927): Acanthocytosis is a type of poikilocytosis characterized by the presence of spikes on the cell surface. The cells have an irregular shape resembling many-pointed stars. Evidence: TAS. Frequency: Frequent (HP:0040282). (ORPHA:97280)
- Diarrhea (HP:0002014): Abnormally increased frequency (usually defined as three or more) loose or watery bowel movements a day. Evidence: TAS. Frequency: Frequent (HP:0040282). (ORPHA:97280)
- Nausea and vomiting (HP:0002017): Nausea is a commonly encountered symptom that has been defined as an unpleasant painless subjective feeling that one will imminently vomit. Vomiting has been defined as the forceful expulsion of the contents of the stomach, duodenum, or jejunum through the oral cavity. While nausea and vomiting are often thought to exist on a temporal continuum, this is not always the case. There are situations when severe nausea may be present without emesis and less frequently, when emesis may be present without preceding nausea. Evidence: TAS. Frequency: Frequent (HP:0040282). (ORPHA:97280)
- Constipation (HP:0002019): Infrequent or difficult evacuation of feces. Evidence: TAS. Frequency: Frequent (HP:0040282). (ORPHA:97280)
- Anorexia (HP:0002039): Lack of desire to eat (loss of appetite). Evidence: TAS. Frequency: Frequent (HP:0040282). (ORPHA:97280)
- Hepatomegaly (HP:0002240): Abnormally increased size of the liver. Evidence: TAS. Frequency: Frequent (HP:0040282). (ORPHA:97280)
- Episodic abdominal pain (HP:0002574): An intermittent form of abdominal pain. Evidence: TAS. Frequency: Frequent (HP:0040282). (ORPHA:97280)
- Poor appetite (HP:0004396): A reduced desire to eat. Evidence: TAS. Frequency: Frequent (HP:0040282). (ORPHA:97280)
- Abnormal blistering of the skin (HP:0008066): The presence of one or more bullae on the skin, defined as fluid-filled blisters more than 5 mm in diameter with thin walls. Evidence: TAS. Frequency: Frequent (HP:0040282). (ORPHA:97280)
- Stomatitis (HP:0010280): Stomatitis is an inflammation of the mucous membranes of any of the structures in the mouth. Evidence: TAS. Frequency: Frequent (HP:0040282). (ORPHA:97280)
- Chronic fatigue (HP:0012432): Subjective feeling of tiredness characterized by a lack of energy and motivation that persists for six months or longer. Evidence: TAS. Frequency: Frequent (HP:0040282). (ORPHA:97280)
- Necrolytic migratory erythema (HP:0031181): Acral or periorificial lesions that evolve in recurrent crops, with an annular and migratory distribution. Evidence: TAS. Frequency: Frequent (HP:0040282). (ORPHA:97280)
- Depression (HP:0000716): Frequently experiencing feelings of being down, miserable, and/or hopeless; struggling to recover from these moods; having a pessimistic outlook on the future; feeling a pervasive sense of shame; having a low self-worth; experiencing thoughts of suicide and engaging in suicidal behavior. Evidence: TAS. Frequency: Occasional (HP:0040283). (ORPHA:97280)
- Intermittent jaundice (HP:0001046): Jaundice that is sometimes present, sometimes not. Evidence: TAS. Frequency: Occasional (HP:0040283). (ORPHA:97280)
- Intrahepatic cholestasis (HP:0001406): Impairment of bile flow due to obstruction in the small bile ducts within the liver. Evidence: TAS. Frequency: Occasional (HP:0040283). (ORPHA:97280)
- Abnormal abdomen morphology (HP:0001438): A structural abnormality of the abdomen ('belly'), that is, the part of the body between the pelvis and the thorax. Evidence: TAS. Frequency: Occasional (HP:0040283). (ORPHA:97280)
- Ascites (HP:0001541): Accumulation of fluid in the peritoneal cavity (between the layers of the peritoneum that lines the abdomen). Evidence: TAS. Frequency: Occasional (HP:0040283). (ORPHA:97280)
- Thromboembolism (HP:0001907): The formation of a blood clot inside a blood vessel that subsequently travels through the blood stream from the site where it formed to another location in the body, generally leading to vascular occlusion at the distant site. Evidence: TAS. Frequency: Occasional (HP:0040283). (ORPHA:97280)
- Gastrointestinal hemorrhage (HP:0002239): Hemorrhage affecting the gastrointestinal tract. Evidence: TAS. Frequency: Occasional (HP:0040283). (ORPHA:97280)
- Steatorrhea (HP:0002570): Greater than normal amounts of fat in the feces. This is a result of malabsorption of lipids in the small intestine and results in frothy foul-smelling fecal matter that floats. Evidence: TAS. Frequency: Occasional (HP:0040283). (ORPHA:97280)
- Intestinal obstruction (HP:0005214): Blockage or impairment of the normal flow of the contents of the intestine towards the anal canal. Evidence: TAS. Frequency: Occasional (HP:0040283). (ORPHA:97280)
- Extrahepatic cholestasis (HP:0012334): Impairment of bile flow due to obstruction in large bile ducts outside the liver. Evidence: TAS. Frequency: Occasional (HP:0040283). (ORPHA:97280)
- Lack of bowel sounds (HP:0030145): Complete lack of abdominal sounds as assayed by examination of the abdomen with a stethoscope. Evidence: TAS. Frequency: Occasional (HP:0040283). (ORPHA:97280)
- Abnormal gastrointestinal motility (HP:0030895): An anomaly of the muscular contractions that propel food though the gastrointestinal tract. Evidence: TAS. Frequency: Occasional (HP:0040283). (ORPHA:97280)
- Abnormality of the thyroid gland (HP:0000820): An abnormality of the thyroid gland. Evidence: TAS. Frequency: Very rare (HP:0040284). (ORPHA:97280)
- Increased circulating gonadotropin level (HP:0000837): Overproduction of gonadotropins (FSH, LH) by the anterior pituitary gland. Evidence: TAS. Frequency: Very rare (HP:0040284). (ORPHA:97280)
- Elevated circulating growth hormone concentration (HP:0000845): Acromegaly is a condition resulting from overproduction of growth hormone by the pituitary gland in persons with closed epiphyses, and consists chiefly in the enlargement of the distal parts of the body. The circumference of the skull increases, the nose becomes broad, the tongue becomes enlarged, the facial features become coarsened, the mandible grows excessively, and the teeth become separated. The fingers and toes grow chiefly in thickness. Evidence: TAS. Frequency: Very rare (HP:0040284). (ORPHA:97280)
- Increased circulating prolactin concentration (HP:0000870): The presence of abnormally increased levels of prolactin in the blood. Prolactin is a peptide hormone produced by the anterior pituitary gland that plays a role in breast development and lactation during pregnancy. Evidence: TAS. Frequency: Very rare (HP:0040284). (ORPHA:97280)
- Subcutaneous lipoma (HP:0001031): The presence of subcutaneous lipoma. Evidence: TAS. Frequency: Very rare (HP:0040284). (ORPHA:97280)
- Pituitary adenoma (HP:0002893): A benign epithelial tumor derived from intrinsic cells of the adenohypophysis (anterior pituitary). Evidence: TAS. Frequency: Very rare (HP:0040284). (ORPHA:97280)
- Parathyroid adenoma (HP:0002897): A benign tumor of the parathyroid gland that can cause hyperparathyroidism. Evidence: TAS. Frequency: Very rare (HP:0040284). (ORPHA:97280)
- Hypercalcemia (HP:0003072): The concentration of calcium in the blood circulation is above the upper limit of normal. Evidence: TAS. Frequency: Very rare (HP:0040284). (ORPHA:97280)
- Increased circulating cortisol level (HP:0003118): Overproduction of the hormone of cortisol by the adrenal cortex, resulting in a characteristic combination of clinical symptoms termed Cushing syndrome, with truncal obesity, a round, full face, striae atrophicae and acne, muscle weakness, and other features. Evidence: TAS. Frequency: Very rare (HP:0040284). (ORPHA:97280)
- Primary hyperparathyroidism (HP:0008200): A type of hyperparathyroidism caused by a primary abnormality of the parathyroid glands (e.g., adenoma, carcinoma, hyperplasia). Primary hyperparathyroidism is associated with hyercalcemia. Evidence: TAS. Frequency: Very rare (HP:0040284). (ORPHA:97280)
- Adrenocortical adenoma (HP:0008256): Adrenocortical adenomas are benign tumors of the adrenal cortex. Evidence: TAS. Frequency: Very rare (HP:0040284). (ORPHA:97280)
These phenotypes are associated with the disease Glucagonoma (ORPHA:97280).